Phenotypes associated with the disease Neurotrophic keratopathy (ORPHA:137596):
- Abnormal fifth cranial nerve morphology (HP:0010824): Any structural abnormality of the fifth cranial nerve. Evidence: TAS. Frequency: Very frequent (HP:0040281). (ORPHA:137596)
- Decreased corneal sensation (HP:0012155): Reduced ability of the cornea to respond to stimulation. Evidence: TAS. Frequency: Very frequent (HP:0040281). (ORPHA:137596)
- Slow decrease in visual acuity (HP:0007924). Evidence: TAS. Frequency: Frequent (HP:0040282). (ORPHA:137596)
- Astigmatism (HP:0000483): A type of refraction error associated with abnormal curvatures on the anterior and/or posterior surface of the cornea. Evidence: TAS. Frequency: Occasional (HP:0040283). (ORPHA:137596)
- Recurrent corneal erosions (HP:0000495): The presence of recurrent corneal epithelial erosions. Although most corneal epithelial defects heal quickly, some may show recurrent ulcerations. Evidence: TAS. Frequency: Occasional (HP:0040283). (ORPHA:137596)
- Corneal scarring (HP:0000559). Evidence: TAS. Frequency: Occasional (HP:0040283). (ORPHA:137596)
- Blurred vision (HP:0000622): Lack of sharpness of vision resulting in the inability to see fine detail. Evidence: TAS. Frequency: Occasional (HP:0040283). (ORPHA:137596)
- Lacrimation abnormality (HP:0000632): Abnormality of tear production. Evidence: TAS. Frequency: Occasional (HP:0040283). (ORPHA:137596)
- Diabetes mellitus (HP:0000819): A group of abnormalities characterized by hyperglycemia and glucose intolerance. Evidence: TAS. Frequency: Occasional (HP:0040283). (ORPHA:137596)
- Corneal stromal edema (HP:0012040): Abnormal accumulation of fluid and swelling of the stroma of cornea. Evidence: TAS. Frequency: Occasional (HP:0040283). (ORPHA:137596)
- Anterior uveitis (HP:0012122): Inflammation of the uveal tract in which the primary site of inflammation is the anterior chamber. Evidence: TAS. Frequency: Occasional (HP:0040283). (ORPHA:137596)
- Corneal ulceration (HP:0012804): Disruption of the epithelial layer of the cornea with involvement of the underlying stroma. Evidence: TAS. Frequency: Occasional (HP:0040283). (ORPHA:137596)
- Allodynia (HP:0012533): Pain due to a stimulus that does not normally provoke pain. Evidence: TAS. Frequency: Very rare (HP:0040284). (ORPHA:137596)
- Corneal perforation (HP:0100583): A rupture of the cornea through which a portion of the iris protrudes. Evidence: TAS. Frequency: Very rare (HP:0040284). (ORPHA:137596)
- Hyperesthesia (HP:0100963): Increased sensitivity to stimulation, excluding the special senses, which may refer to various modes of cutaneous sensibility including touch and thermal sensation without pain, as well as to pain. Evidence: TAS. Frequency: Very rare (HP:0040284). (ORPHA:137596)